Phenotypes associated with the disease macrocephaly/megalencephaly syndrome, autosomal recessive (OMIM:248000):
- Scaphocephaly (HP:0030799): Scaphocephaly is a subtype of dolichocephaly where the anterior and posterior aspects of the cranial vault are pointed (boat-shaped). Scaphocephaly is caused by a precocious fusion of sagittal suture without other associated synostosis. Evidence: PCS. Frequency: 3/4. (PMID:23687350;PMID:24515783)
- Astigmatism (HP:0000483): A type of refraction error associated with abnormal curvatures on the anterior and/or posterior surface of the cornea. Evidence: TAS. Frequency: Occasional (HP:0040283). (OMIM:248000)
- Megalencephaly (HP:0001355): Diffuse enlargement of the entire cerebral hemispheres leading to macrocephaly (with or without overlying cortical dysplasia). Evidence: PCS. (PMID:24515783)
- Mild intellectual disability (HP:0001256): Mild intellectual disability (ID) is defined as a type of ID characterized by mildly sub-average adaptive functioning and intellectual functioning, with an intelligence quotient (IQ) the range of 50-69. Evidence: PCS. Frequency: 4/4. (PMID:23687350;PMID:24515783)
- Strabismus (HP:0000486): A misalignment of the eyes so that the visual axes deviate from bifoveal fixation. The classification of strabismus may be based on a number of features including the relative position of the eyes, whether the deviation is latent or manifest, intermittent or constant, concomitant or otherwise and according to the age of onset and the relevance of any associated refractive error. Evidence: PCS. Frequency: 1/2. (PMID:24515783)
- Infantile onset (HP:0003593): Onset of signs or symptoms of disease between 28 days to one year of life. Evidence: PCS. Frequency: 2/2. (PMID:24515783)
- Coarse facial features (HP:0000280): Absence of fine and sharp appearance of brows, nose, lips, mouth, and chin, usually because of rounded and heavy features or thickened skin with or without thickening of subcutaneous and bony tissues. Evidence: IEA. (OMIM:248000)
- Depression (HP:0000716): Frequently experiencing feelings of being down, miserable, and/or hopeless; struggling to recover from these moods; having a pessimistic outlook on the future; feeling a pervasive sense of shame; having a low self-worth; experiencing thoughts of suicide and engaging in suicidal behavior. Evidence: TAS. (OMIM:248000)
- Calcium oxalate nephrolithiasis (HP:0008672): The presence of calcium- and oxalate-containing calculi (stones) in the kidneys. Evidence: PCS. Frequency: 2/2. (PMID:24515783)
- Broad forehead (HP:0000337): Width of the forehead or distance between the frontotemporales is more than two standard deviations above the mean (objective); or apparently increased distance between the two sides of the forehead. Evidence: PCS. Frequency: 2/2. (PMID:23687350)
- Hydrocephalus (HP:0000238): Hydrocephalus is an active distension of the ventricular system of the brain resulting from inadequate passage of CSF from its point of production within the cerebral ventricles to its point of absorption into the systemic circulation. Evidence: PCS. Frequency: 0/2. (PMID:24515783)
- Genu valgum (HP:0002857): The legs angle inward, such that the knees are close together and the ankles far apart. Evidence: PCS. Frequency: 1/2. (PMID:24515783)
- Adrenal medullary hypoplasia (HP:0008239): Developmental hypoplasia of the adrenal medulla. Evidence: IEA. (OMIM:248000)
- Macrocephaly (HP:0000256): Occipitofrontal (head) circumference greater than 97th centile compared to appropriate, age matched, sex-matched normal standards. Alternatively, a apparently increased size of the cranium. Evidence: PCS. Frequency: 4/4. (PMID:23687350;PMID:24515783)
- Intellectual disability (HP:0001249): The term intellectual disability or intellectual developmental disorder is used to describe significantly sub-average intellectual and adaptive functioning based on clinical assessment and as measured by individually administered, appropriately normed, standardized and validated tests of intellectual functioning and adaptive behavior, with onset during the developmental period from infancy through adolescence. Evidence: IEA. (OMIM:248000)
- Delayed speech and language development (HP:0000750): A degree of language development that is significantly below the norm for a child of a specified age. Evidence: TAS. (OMIM:248000)
- Global developmental delay (HP:0001263): A delay in the achievement of motor or mental milestones in the domains of development of a child, including motor skills, speech and language, cognitive skills, and social and emotional skills. This term should only be used to describe children younger than five years of age. Evidence: TAS. (OMIM:248000)
- Patellar subluxation (HP:0010499): The kneecap normally is located within the groove termed trochlea on the distal femur and can slide up and down in it. Patellar subluxation refers to an unstable kneecap that does not slide centrally within its groove, i.e., a partial dislocation of the patella. Evidence: PCS. Frequency: 2/2. (PMID:24515783)
- Psychosis (HP:0000709): A condition characterized by changes in personality and thought patterns, often accompanied by hallucinations and delusional beliefs, is known as psychosis. Evidence: PCS. Frequency: 2/2. (PMID:24515783)
- Thick corpus callosum (HP:0007074): Increased vertical dimension of the corpus callosum. This feature can be visualized by sagittal sections on magnetic resonance tomography imaging of the brain. Evidence: PCS. Frequency: 2/2. (PMID:23687350)
- Celiac disease (HP:0002608): Celiac disease (CD) is an autoimmune condition affecting the small intestine, triggered by the ingestion of gluten, the protein fraction of wheat, barley, and rye. Clinical manifestations of CD are highly variable and include both gastrointestinal and non-gastrointestinal features. The hallmark of CD is an immune-mediated enteropathy. This term is included because the occurrence of CD is seen as a feature of a number of other diseases. Evidence: PCS. Frequency: 2/2. (PMID:24515783)
- Autosomal recessive inheritance (HP:0000007): A mode of inheritance that is observed for traits related to a gene encoded on one of the autosomes (i.e., the human chromosomes 1-22) in which a trait manifests in individuals with two pathogenic alleles, either homozygotes (two copies of the same mutant allele) or compound heterozygotes (whereby each copy of a gene has a distinct mutant allele). Evidence: PCS. (PMID:23687350)
- Optic atrophy (HP:0000648): Atrophy of the optic nerve. Optic atrophy results from the death of the retinal ganglion cell axons that comprise the optic nerve and manifesting as a pale optic nerve on fundoscopy. Evidence: IEA. (OMIM:248000)
- Pointed chin (HP:0000307): A marked tapering of the lower face to the chin. Evidence: PCS. Frequency: 2/2. (PMID:24515783)
- Dolichocephaly (HP:0000268): An abnormality of skull shape characterized by a increased anterior-posterior diameter, i.e., an increased antero-posterior dimension of the skull. Cephalic index less than 76%. Alternatively, an apparently increased antero-posterior length of the head compared to width. Often due to premature closure of the sagittal suture. Evidence: PCS. Frequency: 2/2. (PMID:24515783)
- Mandibular prognathia (HP:0000303): Abnormal prominence of the chin related to increased length of the mandible. Evidence: TAS. (OMIM:248000)
- Myopia (HP:0000545): An abnormality of refraction characterized by the ability to see objects nearby clearly, while objects in the distance appear blurry. Evidence: PCS. Frequency: 2/2. (PMID:24515783)